Phenotypes associated with the disease Epidermolysis bullosa simplex with anodontia/hypodontia (ORPHA:2325):
- Abnormality of the face (HP:0000271): An abnormality of the face. Evidence: TAS. Frequency: Frequent (HP:0040282). (ORPHA:2325)
- Mandibular prognathia (HP:0000303): Abnormal prominence of the chin related to increased length of the mandible. Evidence: TAS. Frequency: Frequent (HP:0040282). (ORPHA:2325)
- Short philtrum (HP:0000322): Distance between nasal base and midline upper lip vermilion border more than 2 SD below the mean. Alternatively, an apparently decreased distance between nasal base and midline upper lip vermilion border. Evidence: TAS. Frequency: Frequent (HP:0040282). (ORPHA:2325)
- Hearing impairment (HP:0000365): A decreased magnitude of the sensory perception of sound. Evidence: TAS. Frequency: Occasional (HP:0040283). (ORPHA:2325)
- Myopia (HP:0000545): An abnormality of refraction characterized by the ability to see objects nearby clearly, while objects in the distance appear blurry. Evidence: TAS. Frequency: Very frequent (HP:0040281). (ORPHA:2325)
- Abnormal dental enamel morphology (HP:0000682): An abnormality of the dental enamel. Evidence: TAS. Frequency: Very frequent (HP:0040281). (ORPHA:2325)
- Delayed eruption of teeth (HP:0000684): Delayed tooth eruption, which can be defined as tooth eruption more than 2 SD beyond the mean eruption age. Evidence: TAS. Frequency: Very frequent (HP:0040281). (ORPHA:2325)
- Ectopia lentis (HP:0001083): Dislocation or malposition of the crystalline lens of the eye. A partial displacement (or dislocation) of the lens is described as a subluxation of the lens, while a complete displacement is termed luxation of the lens. A complete displacement occurs if the lens is completely outside the patellar fossa of the lens, either in the anterior chamber, in the vitreous, or directly on the retina. If the lens is partially displaced but still contained within the lens space, then it is termed subluxation. Evidence: TAS. Frequency: Frequent (HP:0040282). (ORPHA:2325)
- Abnormal fingernail morphology (HP:0001231): An abnormality of the fingernails. Evidence: TAS. Frequency: Very frequent (HP:0040281). (ORPHA:2325)
- Alopecia (HP:0001596): A noncongenital process of hair loss, which may progress to partial or complete baldness. Evidence: TAS. Frequency: Frequent (HP:0040282). (ORPHA:2325)
- Hypoplastic toenails (HP:0001800): Underdevelopment of the toenail. Evidence: TAS. Frequency: Very frequent (HP:0040281). (ORPHA:2325)
- Anemia (HP:0001903): A reduction in erythrocytes volume or hemoglobin concentration. Evidence: TAS. Frequency: Occasional (HP:0040283). (ORPHA:2325)
- Sparse scalp hair (HP:0002209): Decreased number of hairs per unit area of skin of the scalp. Evidence: TAS. Frequency: Very frequent (HP:0040281). (ORPHA:2325)
- Fatigable weakness (HP:0003473): A type of weakness that occurs after a muscle group is used and lessens if the muscle group has some rest. That is, there is diminution of strength with repetitive muscle actions. Evidence: TAS. Frequency: Occasional (HP:0040283). (ORPHA:2325)
- Abnormal blistering of the skin (HP:0008066): The presence of one or more bullae on the skin, defined as fluid-filled blisters more than 5 mm in diameter with thin walls. Evidence: TAS. Frequency: Very frequent (HP:0040281). (ORPHA:2325)
- Tooth agenesis (HP:0009804): The absence of one or more teeth from the normal series by a failure to develop. Evidence: TAS. Frequency: Very frequent (HP:0040281). (ORPHA:2325)
- Cognitive impairment (HP:0100543): Abnormal cognition is characterized by deficits in thinking, reasoning, or remembering. Evidence: TAS. Frequency: Frequent (HP:0040282). (ORPHA:2325)
- Toenail dysplasia (HP:0100797): An abnormality of the development of the toenails. Evidence: TAS. Frequency: Frequent (HP:0040282). (ORPHA:2325)
- Fingernail dysplasia (HP:0100798): An abnormality of the development of the fingernails. Evidence: TAS. Frequency: Very frequent (HP:0040281). (ORPHA:2325)